Phenotypes associated with the disease familial hypobetalipoproteinemia 1 (OMIM:615558):
- Elevated circulating aspartate aminotransferase concentration (HP:0031956): The concentration of aspartate aminotransferase (AST) in the blood circulation is above the upper limit of normal. Evidence: PCS. Frequency: 3/3. (PMID:21981844)
- Decreased circulating LDL-C concentration (HP:0003563): The concentration of low-density lipoprotein cholesterol in the blood circulation is below the lower limit of normal. Evidence: PCS. Frequency: 4/4. (PMID:21981844;PMID:1939657)
- Hypertriglyceridemia (HP:0002155): An abnormal increase in the level of triglycerides in the blood. Evidence: PCS. Frequency: 0/1. (PMID:1939657)
- Decreased circulating HDL-C concentration (HP:0003233): The concentration of high-density lipoprotein cholesterol in the blood circulation is below the lower limit of normal. Evidence: PCS. Frequency: 3/3. (PMID:21981844)
- Hypocholesterolemia (HP:0003146): An decreased concentration of cholesterol in the blood. Evidence: PCS. Frequency: 3/3. (PMID:21981844)
- Ataxia (HP:0001251): Ataxia refers to impaired coordination of voluntary muscle movement. Cerebellar ataxia refers to ataxia due to dysfunction of the cerebellum. This causes a variety of elementary neurological deficits including asynergy (lack of coordination between muscles, limbs and joints), dysmetria (lack of ability to judge distances that can lead to under- or overshoot in grasping movements), and dysdiadochokinesia (inability to perform rapid movements requiring antagonizing muscle groups to be switched on and off repeatedly). Evidence: TAS. (OMIM:615558)
- Infantile onset (HP:0003593): Onset of signs or symptoms of disease between 28 days to one year of life. Evidence: PCS. Frequency: 1/1. (PMID:21981844)
- Steatorrhea (HP:0002570): Greater than normal amounts of fat in the feces. This is a result of malabsorption of lipids in the small intestine and results in frothy foul-smelling fecal matter that floats. Evidence: PCS. Frequency: 3/3. (PMID:21981844)
- Elevated circulating alanine aminotransferase concentration (HP:0031964): An abnormally high concentration in the circulation of alanine aminotransferase (ALT). Evidence: PCS. Frequency: 3/3. (PMID:21981844)
- Decreased circulating vitamin E concentration (HP:0100513): A reduced concentration of vitamin E in the blood circulation. Vitamin E is a lipophilic vitamin that is also known as alpha-tocopherol. Evidence: PCS. Frequency: 3/3. (PMID:21981844)
- Acanthocytosis (HP:0001927): Acanthocytosis is a type of poikilocytosis characterized by the presence of spikes on the cell surface. The cells have an irregular shape resembling many-pointed stars. Evidence: PCS. Frequency: 3/3. (PMID:21981844)
- Reduced circulating vitamin A concentration (HP:0004905): Concentration of vitamin A below the lower limit of normal in the blood circulation. Evidence: PCS. Frequency: 3/3. (PMID:21981844)
- Retinal degeneration (HP:0000546): A nonspecific term denoting progressive loss of the retinal pigment epithelium (RPE) and/or neurosensory retinal cells. Evidence: TAS. (OMIM:615558)
- Autosomal recessive inheritance (HP:0000007): A mode of inheritance that is observed for traits related to a gene encoded on one of the autosomes (i.e., the human chromosomes 1-22) in which a trait manifests in individuals with two pathogenic alleles, either homozygotes (two copies of the same mutant allele) or compound heterozygotes (whereby each copy of a gene has a distinct mutant allele). Evidence: PCS. (PMID:1939657)
- Rod-cone dystrophy (HP:0000510): An inherited retinal disease subtype in which the rod photoreceptors appear to be more severely affected than the cone photoreceptors. Typical presentation is with nyctalopia (due to rod dysfunction) followed by loss of mid-peripheral field of vision, which gradually extends and leaves many patients with a small central island of vision due to the preservation of macular cones. Evidence: PCS. Frequency: 0/1. (PMID:21981844)
- Diminished deep tendon reflex (HP:0001315): A reduction (hyporeflexia) or complete absence (areflexia) of the involuntary muscle contraction normally elicited by a reflex stimulus, such as tapping a deep tendon. Evidence: TAS. (OMIM:615558)